- Anosmia (HP:0000458): An inability to perceive odors. This is a general term describing inability to smell arising in any part of the process of smelling from absorption of odorants into the nasal mucous overlying the olfactory epithelium, diffusion to the cilia, binding to olfactory receptor sites, generation of action potentials in olfactory neurons, and perception of a smell. Evidence: IEA. (OMIM:301700)
- X-linked inheritance (HP:0001417): A mode of inheritance that is observed for traits related to a gene encoded on the X chromosome. Evidence: IEA. (OMIM:301700)
These phenotypes are associated with the disease anosmia, isolated congenital, X-linked (OMIM:301700).